Phenotypes associated with the disease mitochondrial complex I deficiency, nuclear type 27 (OMIM:618248):
- Neurogenic bladder (HP:0000011): A type of bladder dysfunction caused by neurologic damage. Neurogenic bladder can be flaccid or spastic. Common manifestatios of neurogenic bladder are overflow incontinence, frequency, urgency, urge incontinence, and retention. Evidence: PCS. Frequency: 1/2. (PMID:22499348)
- Spastic tetraplegia (HP:0002510): Spastic paralysis affecting all four limbs. Evidence: PCS. Frequency: 1/2. (PMID:22499348)
- Hypotonia (HP:0001252): Hypotonia is an abnormally low muscle tone (the amount of tension or resistance to movement in a muscle). Even when relaxed, muscles have a continuous and passive partial contraction which provides some resistance to passive stretching. Hypotonia thus manifests as diminished resistance to passive stretching. Hypotonia is not the same as muscle weakness, although the two conditions can co-exist. Evidence: PCS. Frequency: 1/2. (PMID:22499348)
- Global developmental delay (HP:0001263): A delay in the achievement of motor or mental milestones in the domains of development of a child, including motor skills, speech and language, cognitive skills, and social and emotional skills. This term should only be used to describe children younger than five years of age. Evidence: PCS. Frequency: 2/2. (PMID:22499348)
- Infantile onset (HP:0003593): Onset of signs or symptoms of disease between 28 days to one year of life. Evidence: PCS. Frequency: 2/2. (PMID:22499348)
- Ataxia (HP:0001251): Ataxia refers to impaired coordination of voluntary muscle movement. Cerebellar ataxia refers to ataxia due to dysfunction of the cerebellum. This causes a variety of elementary neurological deficits including asynergy (lack of coordination between muscles, limbs and joints), dysmetria (lack of ability to judge distances that can lead to under- or overshoot in grasping movements), and dysdiadochokinesia (inability to perform rapid movements requiring antagonizing muscle groups to be switched on and off repeatedly). Evidence: PCS. Frequency: 1/2. (PMID:22499348)
- Autosomal recessive inheritance (HP:0000007): A mode of inheritance that is observed for traits related to a gene encoded on one of the autosomes (i.e., the human chromosomes 1-22) in which a trait manifests in individuals with two pathogenic alleles, either homozygotes (two copies of the same mutant allele) or compound heterozygotes (whereby each copy of a gene has a distinct mutant allele). Evidence: PCS. (PMID:22499348)
- Optic atrophy (HP:0000648): Atrophy of the optic nerve. Optic atrophy results from the death of the retinal ganglion cell axons that comprise the optic nerve and manifesting as a pale optic nerve on fundoscopy. Evidence: PCS. Frequency: 1/2. (PMID:22499348)
- Decreased activity of mitochondrial complex I (HP:0011923): A reduction in the activity of the mitochondrial respiratory chain complex I, which is part of the electron transport chain in mitochondria. Evidence: PCS. Frequency: 2/2. (PMID:22499348)
- Intellectual disability (HP:0001249): The term intellectual disability or intellectual developmental disorder is used to describe significantly sub-average intellectual and adaptive functioning based on clinical assessment and as measured by individually administered, appropriately normed, standardized and validated tests of intellectual functioning and adaptive behavior, with onset during the developmental period from infancy through adolescence. Evidence: PCS. Frequency: 1/2. (PMID:22499348)
- Vertical supranuclear gaze palsy (HP:0000511): A supranuclear gaze palsy is an inability to look in a vertical direction as a result of cerebral impairment. There is a loss of the voluntary aspect of eye movements, but, as the brainstem is still intact, all the reflex conjugate eye movements are normal. Evidence: PCS. Frequency: 1/2. (PMID:22499348)